Phenotypes associated with the disease arthrogryposis-hyperkeratosis syndrome, lethal form (OMIM:208158):
- Arthrogryposis multiplex congenita (HP:0002804): Multiple congenital contractures in different body areas. Evidence: IEA. (OMIM:208158)